- Fish odor (HP:0410020): Body odor characterized by an offensive body odor and the smell of rotting fish due to the excessive excretion of trimethylamine (TMA) in the urine, sweat, and breath of affected individuals. Evidence: TAS. Frequency: Obligate (HP:0040280). (ORPHA:468726)
- Trimethylaminuria (HP:0003614): Increased concentration of trimethylamine in the urine. Evidence: TAS. Frequency: Very frequent (HP:0040281). (ORPHA:468726)
- Emotional lability (HP:0000712): Unstable emotional experiences and frequent mood changes; emotions that are easily aroused, intense, and/or disproportionate to events and circumstances. Evidence: TAS. Frequency: Frequent (HP:0040282). (ORPHA:468726)
- Dysregulated negative emotional state (HP:0031467): An emotional state characterized by excessive, persistent, or contextually inappropriate negative inner experiences involving emotional arousal and valence. These experiences are often associated with negative perceptions of the self, the future, the past, or the surrounding environment, and may include affective bias such as interpreting neutral or ambiguous stimuli as negative. The intensity, duration, or impact of the state exceeds what would be expected for the individual based on their baseline emotional functioning, the context, cultural norms, or situational triggers, or when it persists despite efforts at self-regulation. Evidence: TAS. Frequency: Frequent (HP:0040282). (ORPHA:468726)
- Low self-esteem (HP:0031469): Persistent, excessively negative, and critical thoughts of one's personal abilities, attributes, or any feature related to the self and self-attitude. The affected individual believes they are a lesser being compared to others in their social peer group. Evidence: TAS. Frequency: Frequent (HP:0040282). (ORPHA:468726)
- Depression (HP:0000716): Frequently experiencing feelings of being down, miserable, and/or hopeless; struggling to recover from these moods; having a pessimistic outlook on the future; feeling a pervasive sense of shame; having a low self-worth; experiencing thoughts of suicide and engaging in suicidal behavior. Evidence: TAS. Frequency: Occasional (HP:0040283). (ORPHA:468726)
- Aggressive behavior (HP:0000718): Behavior or an act aimed at harming a person, animal, or physical property (e.g., acts of physical violence; shouting, swearing, and using harsh language; slashing someone's tires). Evidence: TAS. Frequency: Occasional (HP:0040283). (ORPHA:468726)
- Anxiety (HP:0000739): Intense feelings of nervousness, tension, or panic often arise in response to interpersonal stresses. There is worry about the negative effects of past unpleasant experiences and future negative possibilities. Individuals may feel fearful, apprehensive, or threatened by uncertainty, and they may also have fears of falling apart or losing control. Evidence: TAS. Frequency: Occasional (HP:0040283). (ORPHA:468726)
- Obsessive-compulsive trait (HP:0008770): The presence of one or more obsessive-compulsive personality traits. Obsessions refer to persistent intrusive thoughts, and compulsions to intrusive behaviors, which the affected person experiences as involuntary, senseless, or repugnant. Evidence: TAS. Frequency: Occasional (HP:0040283). (ORPHA:468726)
- Paranoia (HP:0011999): The feeling and belief that one is being targeted or is a focus of negative or untoward actions, overt or covert, from others. The affected individual expresses a concern that people are in general against the individual and are engaging in subtle behaviors to make things difficult for them. The origins of such thinking may arise from real events and become amplified over time. Paranoia may also arise in the absence of any action or interaction between the person and their environment. Evidence: TAS. Frequency: Occasional (HP:0040283). (ORPHA:468726)
These phenotypes are associated with the disease Severe primary trimethylaminuria (ORPHA:468726).